- Lipoma (HP:0012032): Benign neoplasia derived from lipoblasts or lipocytes of white or brown fat. May be angiomatous or hibernomatous. Evidence: IEA. (OMIM:151700)
- Conjunctival lipoma (HP:0012549): A lipoma (a benign tumor composed of adipose tissue) located in the conjunctiva. Evidence: TAS. (OMIM:151700)
- Autosomal dominant inheritance (HP:0000006): A mode of inheritance that is observed for traits related to a gene encoded on one of the autosomes (i.e., the human chromosomes 1-22) in which a trait manifests in heterozygotes. In the context of medical genetics, an autosomal dominant disorder is caused when a single copy of the mutant allele is present. Males and females are affected equally, and can both transmit the disorder with a risk of 50% for each child of inheriting the mutant allele. Evidence: TAS. (OMIM:151700)
These phenotypes are associated with the disease lipoma of the conjunctiva (OMIM:151700).